Phenotypes associated with the disease Seckel syndrome (ORPHA:808):
- Microcephaly (HP:0000252): Head circumference below 2 standard deviations below the mean for age and gender. Evidence: TAS. Frequency: Very frequent (HP:0040281). (ORPHA:808)
- Narrow face (HP:0000275): Bizygomatic (upper face) and bigonial (lower face) width are both more than 2 standard deviations below the mean (objective); or, an apparent reduction in the width of the upper and lower face (subjective). Evidence: TAS. Frequency: Very frequent (HP:0040281). (ORPHA:808)
- Micrognathia (HP:0000347): Developmental hypoplasia of the mandible. Evidence: TAS. Frequency: Very frequent (HP:0040281). (ORPHA:808)
- Convex nasal ridge (HP:0000444): Nasal ridge curving anteriorly to an imaginary line that connects the nasal root and tip. The nose appears often also prominent, and the columella low. Evidence: TAS. Frequency: Very frequent (HP:0040281). (ORPHA:808)
- Intellectual disability (HP:0001249): The term intellectual disability or intellectual developmental disorder is used to describe significantly sub-average intellectual and adaptive functioning based on clinical assessment and as measured by individually administered, appropriately normed, standardized and validated tests of intellectual functioning and adaptive behavior, with onset during the developmental period from infancy through adolescence. Evidence: TAS. Frequency: Very frequent (HP:0040281). (ORPHA:808)
- Craniosynostosis (HP:0001363): Craniosynostosis refers to the premature closure of the cranial sutures. Primary craniosynostosis refers to the closure of one or more sutures due to abnormalities in skull development, and secondary craniosynostosis results from failure of brain growth. Evidence: TAS. Frequency: Very frequent (HP:0040281). (ORPHA:808)
- Intrauterine growth retardation (HP:0001511): An abnormal restriction of fetal growth with fetal weight below the tenth percentile for gestational age. Evidence: TAS. Frequency: Very frequent (HP:0040281). (ORPHA:808)
- Sandal gap (HP:0001852): A widely spaced gap between the first toe (the great toe) and the second toe. Evidence: TAS. Frequency: Very frequent (HP:0040281). (ORPHA:808)
- Delayed skeletal maturation (HP:0002750): A decreased rate of skeletal maturation. Delayed skeletal maturation can be diagnosed on the basis of an estimation of the bone age from radiographs of specific bones in the human body. Evidence: TAS. Frequency: Very frequent (HP:0040281). (ORPHA:808)
- Clinodactyly of the 5th finger (HP:0004209): Clinodactyly refers to a bending or curvature of the fifth finger in the radial direction (i.e., towards the 4th finger). Evidence: TAS. Frequency: Very frequent (HP:0040281). (ORPHA:808)
- Short stature (HP:0004322): A height below that which is expected according to age and gender norms. Although there is no universally accepted definition of short stature, many refer to "short stature" as height more than 2 standard deviations below the mean for age and gender (or below the 3rd percentile for age and gender dependent norms). Evidence: TAS. Frequency: Very frequent (HP:0040281). (ORPHA:808)
- Cachexia (HP:0004326): Severe weight loss, wasting of muscle, loss of appetite, and general debility related to a chronic disease. Evidence: TAS. Frequency: Very frequent (HP:0040281). (ORPHA:808)
- Prematurely aged appearance (HP:0007495). Evidence: TAS. Frequency: Very frequent (HP:0040281). (ORPHA:808)
- Mild global developmental delay (HP:0011342): A mild delay in the achievement of motor or mental milestones in the domains of development of a child. Evidence: TAS. Frequency: Very frequent (HP:0040281). (ORPHA:808)
- Cognitive impairment (HP:0100543): Abnormal cognition is characterized by deficits in thinking, reasoning, or remembering. Evidence: TAS. Frequency: Very frequent (HP:0040281). (ORPHA:808)
- Abnormal earlobe morphology (HP:0000363): An abnormality of the lobule of pinna. Evidence: TAS. Frequency: Frequent (HP:0040282). (ORPHA:808)
- Absent earlobe (HP:0000387): Absence of fleshy non-cartilaginous tissue inferior to the tragus and incisura. Evidence: TAS. Frequency: Frequent (HP:0040282). (ORPHA:808)
- Downslanted palpebral fissures (HP:0000494): The palpebral fissure inclination is more than two standard deviations below the mean. Evidence: TAS. Frequency: Frequent (HP:0040282). (ORPHA:808)
- Glaucoma (HP:0000501): Glaucoma refers loss of retinal ganglion cells in a characteristic pattern of optic neuropathy usually associated with increased intraocular pressure. Evidence: TAS. Frequency: Frequent (HP:0040282). (ORPHA:808)
- Abnormal dental enamel morphology (HP:0000682): An abnormality of the dental enamel. Evidence: TAS. Frequency: Frequent (HP:0040282). (ORPHA:808)
- Hip dysplasia (HP:0001385): The presence of developmental dysplasia of the hip. Evidence: TAS. Frequency: Frequent (HP:0040282). (ORPHA:808)
- Sparse scalp hair (HP:0002209): Decreased number of hairs per unit area of skin of the scalp. Evidence: TAS. Frequency: Frequent (HP:0040282). (ORPHA:808)
- Tooth agenesis (HP:0009804): The absence of one or more teeth from the normal series by a failure to develop. Evidence: TAS. Frequency: Frequent (HP:0040282). (ORPHA:808)
- Cone-shaped epiphysis (HP:0010579): Cone-shaped epiphyses (also known as coned epiphyses) are epiphyses that invaginate into cupped metaphyses. That is, the epiphysis has a cone-shaped distal extension resulting from increased growth of the central portion of the epiphysis relative to its periphery. Evidence: TAS. Frequency: Frequent (HP:0040282). (ORPHA:808)
- Scoliosis (HP:0002650): The presence of an abnormal lateral curvature of the spine. Evidence: TAS. Frequency: Occasional (HP:0040283). (ORPHA:808)
- Joint hypermobility (HP:0001382): The capability that a joint (or a group of joints) has to move, passively and/or actively, beyond normal limits along physiological axes. Evidence: TAS. Frequency: Frequent (HP:0040282). (ORPHA:808)